- Nuclear cataract (HP:0100018): A nuclear cataract is an opacity or clouding that develops in the lens nucleus. That is, a nuclear cataract is one that is located in the center of the lens. The nucleus tends to darken changing from clear to yellow and sometimes brown. Evidence: PCS. Onset: Congenital onset (HP:0003577). (PMID:23531866)
- Autosomal dominant inheritance (HP:0000006): A mode of inheritance that is observed for traits related to a gene encoded on one of the autosomes (i.e., the human chromosomes 1-22) in which a trait manifests in heterozygotes. In the context of medical genetics, an autosomal dominant disorder is caused when a single copy of the mutant allele is present. Males and females are affected equally, and can both transmit the disorder with a risk of 50% for each child of inheriting the mutant allele. Evidence: PCS. (PMID:23531866)
These phenotypes are associated with the disease cataract 41 (OMIM:116400).